- Atopic dermatitis (HP:0001047): Atopic dermatitis (AD) or atopic eczema is an itchy, inflammatory skin condition with a predilection for the skin flexures. It is characterized by poorly defined erythema with edema, vesicles, and weeping in the acute stage and skin thickening (lichenification) in the chronic stage. Evidence: TAS. (OMIM:605803)
- Eczematoid dermatitis (HP:0000964): Eczema is a form of dermatitis that is characterized by scaly, pruritic, erythematous lesions located on flexural surfaces. Evidence: TAS. (OMIM:605803)
- Autosomal dominant inheritance (HP:0000006): A mode of inheritance that is observed for traits related to a gene encoded on one of the autosomes (i.e., the human chromosomes 1-22) in which a trait manifests in heterozygotes. In the context of medical genetics, an autosomal dominant disorder is caused when a single copy of the mutant allele is present. Males and females are affected equally, and can both transmit the disorder with a risk of 50% for each child of inheriting the mutant allele. Evidence: TAS. (OMIM:605803)
These phenotypes are associated with the disease dermatitis, atopic, 2 (OMIM:605803).